- Long penis (HP:0000040): Penile length more than 2 SD above the mean for age. Evidence: TAS. Frequency: Frequent (HP:0040282). (ORPHA:1672)
- Everted lower lip vermilion (HP:0000232): An abnormal configuration of the lower lip such that it is turned outward i.e., everted, with the Inner aspect of the lower lip vermilion (normally opposing the teeth) being visible in a frontal view. Evidence: TAS. Frequency: Frequent (HP:0040282). (ORPHA:1672)
- Hydrocephalus (HP:0000238): Hydrocephalus is an active distension of the ventricular system of the brain resulting from inadequate passage of CSF from its point of production within the cerebral ventricles to its point of absorption into the systemic circulation. Evidence: TAS. Frequency: Frequent (HP:0040282). (ORPHA:1672)
- Macrotia (HP:0000400): Median longitudinal ear length greater than two standard deviations above the mean and median ear width greater than two standard deviations above the mean (objective); or, apparent increase in length and width of the pinna (subjective). Evidence: TAS. Frequency: Frequent (HP:0040282). (ORPHA:1672)
- Nystagmus (HP:0000639): Rhythmic, involuntary oscillations of one or both eyes related to abnormality in fixation, conjugate gaze, or vestibular mechanisms. Evidence: TAS. Frequency: Frequent (HP:0040282). (ORPHA:1672)
- Optic atrophy (HP:0000648): Atrophy of the optic nerve. Optic atrophy results from the death of the retinal ganglion cell axons that comprise the optic nerve and manifesting as a pale optic nerve on fundoscopy. Evidence: TAS. Frequency: Occasional (HP:0040283). (ORPHA:1672)
- Atypical behavior (HP:0000708): Atypical behavior is an abnormality in a person's actions that can be controlled or modulated by the will of the individual. While abnormal behaviors can be difficult to control, they are distinct from other abnormal actions that cannot be affected by the individual's will. Evidence: TAS. Frequency: Very frequent (HP:0040281). (ORPHA:1672)
- Abnormality of the hypothalamus-pituitary axis (HP:0000864): Abnormality of the pituitary gland (also known as hypophysis), which is an endocrine gland that protrudes from the bottom of the hypothalamus at the base of the brain. The pituitary gland secretes the hormones ACTH, TSH, PRL, GH, endorphins, FSH, LH, oxytocin, and antidiuretic hormone. The secretion of hormones from the anterior pituitary is under the strict control of hypothalamic hormones, and the posterior pituitary is essentially an extension of the hypothalamus, so that hypothalamus and pituitary gland may be regarded as a functional unit. Evidence: TAS. Frequency: Very frequent (HP:0040281). (ORPHA:1672)
- Hyperhidrosis (HP:0000975): Abnormal excessive perspiration (sweating) despite the lack of appropriate stimuli like hot and humid weather. Evidence: TAS. Frequency: Frequent (HP:0040282). (ORPHA:1672)
- Large hands (HP:0001176). Evidence: TAS. Frequency: Occasional (HP:0040283). (ORPHA:1672)
- Decreased body weight (HP:0004325): Abnormally low body weight. Evidence: TAS. Frequency: Very frequent (HP:0040281). (ORPHA:1672)
- Cachexia (HP:0004326): Severe weight loss, wasting of muscle, loss of appetite, and general debility related to a chronic disease. Evidence: TAS. Frequency: Very frequent (HP:0040281). (ORPHA:1672)
- Neoplasm of the nervous system (HP:0004375): A tumor (abnormal growth of tissue) of the nervous system. Evidence: TAS. Frequency: Very frequent (HP:0040281). (ORPHA:1672)
- Abnormality of movement (HP:0100022): An abnormality of movement with a neurological basis characterized by changes in coordination and speed of voluntary movements. Evidence: TAS. Frequency: Frequent (HP:0040282). (ORPHA:1672)
These phenotypes are associated with the disease Diencephalic syndrome (ORPHA:1672).